Phenotypes associated with the disease primary failure of tooth eruption (OMIM:125350):
- Failure of eruption of permanent teeth (HP:0006352): Lack of tooth eruption of the secondary dentition. Evidence: IEA. (OMIM:125350)
- Hypodontia (HP:0000668): The absence of five or less teeth from the normal series by a failure to develop. Evidence: IEA. (OMIM:125350)
- Persistence of primary teeth (HP:0006335): Persistence of the primary teeth beyond the age by which they normally are shed and replaced by the permanent teeth. Evidence: IEA. (OMIM:125350)
- Autosomal dominant inheritance (HP:0000006): A mode of inheritance that is observed for traits related to a gene encoded on one of the autosomes (i.e., the human chromosomes 1-22) in which a trait manifests in heterozygotes. In the context of medical genetics, an autosomal dominant disorder is caused when a single copy of the mutant allele is present. Males and females are affected equally, and can both transmit the disorder with a risk of 50% for each child of inheriting the mutant allele. Evidence: IEA. (OMIM:125350)